- Gait disturbance (HP:0001288): The term gait disturbance can refer to any disruption of the ability to walk. Evidence: TAS. Frequency: Frequent (HP:0040282). (ORPHA:98764)
- Gaze-evoked nystagmus (HP:0000640): Nystagmus made apparent by looking to the right or to the left. Evidence: TAS. Frequency: Very frequent (HP:0040281). (ORPHA:98764)
- Dysarthria (HP:0001260): Dysarthric speech is a general description referring to a neurological speech disorder characterized by poor articulation. Depending on the involved neurological structures, dysarthria may be further classified as spastic, flaccid, ataxic, hyperkinetic and hypokinetic, or mixed. Evidence: TAS. Frequency: Very frequent (HP:0040281). (ORPHA:98764)
- Tremor (HP:0001337): An unintentional, oscillating to-and-fro muscle movement about a joint axis. Evidence: TAS. Frequency: Very frequent (HP:0040281). (ORPHA:98764)
- Aggressive behavior (HP:0000718): Behavior or an act aimed at harming a person, animal, or physical property (e.g., acts of physical violence; shouting, swearing, and using harsh language; slashing someone's tires). Evidence: TAS. Frequency: Frequent (HP:0040282). (ORPHA:98764)
- Gait disturbance (HP:0001288): The term gait disturbance can refer to any disruption of the ability to walk. Evidence: TAS. Frequency: Frequent (HP:0040282). (ORPHA:98764)
- Pes cavus (HP:0001761): An increase in height of the medial longitudinal arch of the foot that does not flatten on weight bearing (i.e., a distinctly hollow form of the sole of the foot when it is bearing weight). Evidence: TAS. Frequency: Frequent (HP:0040282). (ORPHA:98764)
- Gait ataxia (HP:0002066): A type of ataxia characterized by the impairment of the ability to coordinate the movements required for normal walking. Gait ataxia is characteirzed by a wide-based staggering gait with a tendency to fall. Evidence: TAS. Frequency: Frequent (HP:0040282). (ORPHA:98764)
- Limb ataxia (HP:0002070): A kind of ataxia that affects movements of the extremities. Evidence: TAS. Frequency: Frequent (HP:0040282). (ORPHA:98764)
- Truncal ataxia (HP:0002078): Truncal ataxia is a sign of ataxia characterized by instability of the trunk. It usually occurs during sitting. Evidence: TAS. Frequency: Frequent (HP:0040282). (ORPHA:98764)
- Memory impairment (HP:0002354): An impairment of memory as manifested by a reduced ability to remember things such as dates and names, and increased forgetfulness. Evidence: TAS. Frequency: Frequent (HP:0040282). (ORPHA:98764)
- Sensory axonal neuropathy (HP:0003390): An axonal neuropathy of peripheral sensory nerves. Evidence: TAS. Frequency: Frequent (HP:0040282). (ORPHA:98764)
- Strabismus (HP:0000486): A misalignment of the eyes so that the visual axes deviate from bifoveal fixation. The classification of strabismus may be based on a number of features including the relative position of the eyes, whether the deviation is latent or manifest, intermittent or constant, concomitant or otherwise and according to the age of onset and the relevance of any associated refractive error. Evidence: TAS. Frequency: Occasional (HP:0040283). (ORPHA:98764)
- Red-green dyschromatopsia (HP:0000642): Difficulty with discriminating red and green hues. Evidence: TAS. Frequency: Occasional (HP:0040283). (ORPHA:98764)
- Depression (HP:0000716): Frequently experiencing feelings of being down, miserable, and/or hopeless; struggling to recover from these moods; having a pessimistic outlook on the future; feeling a pervasive sense of shame; having a low self-worth; experiencing thoughts of suicide and engaging in suicidal behavior. Evidence: TAS. Frequency: Occasional (HP:0040283). (ORPHA:98764)
- Mild intellectual disability (HP:0001256): Mild intellectual disability (ID) is defined as a type of ID characterized by mildly sub-average adaptive functioning and intellectual functioning, with an intelligence quotient (IQ) the range of 50-69. Evidence: TAS. Frequency: Occasional (HP:0040283). (ORPHA:98764)
- Cerebellar atrophy (HP:0001272): Cerebellar atrophy is defined as a cerebellum with initially normal structures, in a posterior fossa with normal size, which displays enlarged fissures (interfolial spaces) in comparison to the foliae secondary to loss of tissue. Cerebellar atrophy implies irreversible loss of tissue and result from an ongoing progressive disease until a final stage is reached or a single injury, e.g. an intoxication or infectious event. Evidence: TAS. Frequency: Occasional (HP:0040283). (ORPHA:98764)
- Hand tremor (HP:0002378): An unintentional, oscillating to-and-fro muscle movement affecting the hand. Evidence: TAS. Frequency: Occasional (HP:0040283). (ORPHA:98764)
- Akinesia (HP:0002304): Inability to initiate changes in activity or movement and to perform ordinary volitional movements rapidly and easily. Evidence: TAS. Frequency: Very rare (HP:0040284). (ORPHA:98764)
- Dysgraphia (HP:0010526): A writing disability in the absence of motor or sensory deficits of the upper extremities, resulting in an impairment in the ability to write regardless of the ability to read and not due to intellectual impairment. Evidence: TAS. Frequency: Very rare (HP:0040284). (ORPHA:98764)
These phenotypes are associated with the disease Spinocerebellar ataxia type 27A (ORPHA:98764).